Phenotypes associated with the disease Hooft disease (OMIM:236300):
- Growth abnormality (HP:0001507). Evidence: IEA. (OMIM:236300)
- Abnormality of metabolism/homeostasis (HP:0001939). Evidence: IEA. (OMIM:236300)
- Autosomal recessive inheritance (HP:0000007): A mode of inheritance that is observed for traits related to a gene encoded on one of the autosomes (i.e., the human chromosomes 1-22) in which a trait manifests in individuals with two pathogenic alleles, either homozygotes (two copies of the same mutant allele) or compound heterozygotes (whereby each copy of a gene has a distinct mutant allele). Evidence: IEA. (OMIM:236300)
- Rod-cone dystrophy (HP:0000510): An inherited retinal disease subtype in which the rod photoreceptors appear to be more severely affected than the cone photoreceptors. Typical presentation is with nyctalopia (due to rod dysfunction) followed by loss of mid-peripheral field of vision, which gradually extends and leaves many patients with a small central island of vision due to the preservation of macular cones. Evidence: IEA. (OMIM:236300)
- Intellectual disability (HP:0001249): The term intellectual disability or intellectual developmental disorder is used to describe significantly sub-average intellectual and adaptive functioning based on clinical assessment and as measured by individually administered, appropriately normed, standardized and validated tests of intellectual functioning and adaptive behavior, with onset during the developmental period from infancy through adolescence. Evidence: IEA. (OMIM:236300)
- Leukonychia (HP:0001820): White discoloration of the nails. Evidence: IEA. (OMIM:236300)